- Congenital onset (HP:0003577): A phenotypic abnormality that is present at birth. Evidence: PCS. Frequency: 6/6. (PMID:12687499)
- Abnormal vestibular function (HP:0001751): An abnormality of the functioning of the vestibular apparatus. Evidence: PCS. Frequency: 1/6. (PMID:12687499)
- Sensorineural hearing impairment (HP:0000407): A type of hearing impairment in one or both ears related to an abnormal functionality of the cochlear nerve. Evidence: PCS. Frequency: 6/6. Onset: Congenital onset (HP:0003577). (PMID:12687499)
- Autosomal recessive inheritance (HP:0000007): A mode of inheritance that is observed for traits related to a gene encoded on one of the autosomes (i.e., the human chromosomes 1-22) in which a trait manifests in individuals with two pathogenic alleles, either homozygotes (two copies of the same mutant allele) or compound heterozygotes (whereby each copy of a gene has a distinct mutant allele). Evidence: PCS. (PMID:12687499)
- Early-onset non-progressive night blindness (HP:0007642): A usually nonprogressive (i.e., stationary) form of night blindness with early (presumed to be congenital) onset. Evidence: PCS. Frequency: 1/6. (PMID:12687499)
- Rod-cone dystrophy (HP:0000510): An inherited retinal disease subtype in which the rod photoreceptors appear to be more severely affected than the cone photoreceptors. Typical presentation is with nyctalopia (due to rod dysfunction) followed by loss of mid-peripheral field of vision, which gradually extends and leaves many patients with a small central island of vision due to the preservation of macular cones. Evidence: PCS. Frequency: 1/6. (PMID:12687499)
These phenotypes are associated with the disease autosomal recessive nonsyndromic hearing loss 37 (OMIM:607821).